Phenotypes associated with the disease Microcephalic primordial dwarfism, Montreal type (ORPHA:2617):
- Posteriorly rotated ears (HP:0000358): A type of abnormal location of the ears in which the position of the ears is characterized by posterior rotation (the superior part of the ears is rotated towards the back of the head, and the inferior part of the ears towards the front). Evidence: TAS. Frequency: Very frequent (HP:0040281). (ORPHA:2617)
- Hypertonia (HP:0001276): A condition in which there is increased muscle tone so that arms or legs, for example, are stiff and difficult to move. Evidence: TAS. Frequency: Very frequent (HP:0040281). (ORPHA:2617)
- Hyperreflexia (HP:0001347): Hyperreflexia is the presence of hyperactive stretch reflexes of the muscles. Evidence: TAS. Frequency: Very frequent (HP:0040281). (ORPHA:2617)
- Low posterior hairline (HP:0002162): Hair on the neck extends more inferiorly than usual. Evidence: TAS. Frequency: Very frequent (HP:0040281). (ORPHA:2617)
- Premature graying of hair (HP:0002216): Development of gray hair at a younger than normal age. Evidence: TAS. Frequency: Very frequent (HP:0040281). (ORPHA:2617)
- Alopecia of scalp (HP:0002293). Evidence: TAS. Frequency: Very frequent (HP:0040281). (ORPHA:2617)
- EEG abnormality (HP:0002353): Abnormality observed by electroencephalogram (EEG), which is used to record of the brain's spontaneous electrical activity from multiple electrodes placed on the scalp. Evidence: TAS. Frequency: Very frequent (HP:0040281). (ORPHA:2617)
- Scoliosis (HP:0002650): The presence of an abnormal lateral curvature of the spine. Evidence: TAS. Frequency: Very frequent (HP:0040281). (ORPHA:2617)
- Kyphosis (HP:0002808): Exaggerated anterior convexity of the thoracic vertebral column. Evidence: TAS. Frequency: Very frequent (HP:0040281). (ORPHA:2617)
- Vertebral segmentation defect (HP:0003422): An abnormality related to a defect of vertebral separation during development. Evidence: TAS. Frequency: Very frequent (HP:0040281). (ORPHA:2617)
- Severe short stature (HP:0003510): A severe degree of short stature, more than -4 SD from the mean corrected for age and sex. Evidence: TAS. Frequency: Very frequent (HP:0040281). (ORPHA:2617)
- Reduced bone mineral density (HP:0004349): A reduction of bone mineral density, that is, of the amount of matter per cubic centimeter of bones. Evidence: TAS. Frequency: Very frequent (HP:0040281). (ORPHA:2617)
- Congenital pyloric atresia (HP:0004399): Congenital atresia of the pylorus. Evidence: TAS. Frequency: Very frequent (HP:0040281). (ORPHA:2617)
- Wide intermamillary distance (HP:0006610): A larger than usual distance between the left and right nipple. Evidence: TAS. Frequency: Very frequent (HP:0040281). (ORPHA:2617)
- Abnormal dermatoglyphics (HP:0007477): An abnormality of dermatoglyphs (fingerprints), which are present on fingers, palms, toes, and soles. Evidence: TAS. Frequency: Very frequent (HP:0040281). (ORPHA:2617)
- Prematurely aged appearance (HP:0007495). Evidence: TAS. Frequency: Very frequent (HP:0040281). (ORPHA:2617)
- Shagreen patch (HP:0009721): A plaque representing a connective-tissue nevus. Connective tissue naevi are uncommon skin lesions that occur when the deeper layers of the skin do not develop correctly or the components of these layers occur in the wrong proportion. Shagreen patches are oval-shaped and nevoid, skin-colored or occasionally pigmented, smooth or crinkled. The word shagreen refers to a type of roughened untanned leather. Evidence: TAS. Frequency: Very frequent (HP:0040281). (ORPHA:2617)
- Open bite (HP:0010807): Visible space between the dental arches in occlusion. Evidence: TAS. Frequency: Very frequent (HP:0040281). (ORPHA:2617)
- Abnormal hair quantity (HP:0011362): An abnormal amount of hair. Evidence: TAS. Frequency: Very frequent (HP:0040281). (ORPHA:2617)
- Lipoatrophy (HP:0100578): Localized loss of fat tissue. Evidence: TAS. Frequency: Very frequent (HP:0040281). (ORPHA:2617)
- Cryptorchidism (HP:0000028): Testis in inguinal canal. That is, absence of one or both testes from the scrotum owing to failure of the testis or testes to descend through the inguinal canal to the scrotum. Evidence: TAS. Frequency: Very frequent (HP:0040281). (ORPHA:2617)
- Abnormal palate morphology (HP:0000174): Any abnormality of the palate, i.e., of roof of the mouth. Evidence: TAS. Frequency: Very frequent (HP:0040281). (ORPHA:2617)
- Microcephaly (HP:0000252): Head circumference below 2 standard deviations below the mean for age and gender. Evidence: TAS. Frequency: Very frequent (HP:0040281). (ORPHA:2617)
- Micrognathia (HP:0000347): Developmental hypoplasia of the mandible. Evidence: TAS. Frequency: Very frequent (HP:0040281). (ORPHA:2617)
- Convex nasal ridge (HP:0000444): Nasal ridge curving anteriorly to an imaginary line that connects the nasal root and tip. The nose appears often also prominent, and the columella low. Evidence: TAS. Frequency: Very frequent (HP:0040281). (ORPHA:2617)
- Ptosis (HP:0000508): The upper eyelid margin is positioned 3 mm or more lower than usual and covers the superior portion of the iris (objective); or, the upper lid margin obscures at least part of the pupil (subjective). Evidence: TAS. Frequency: Very frequent (HP:0040281). (ORPHA:2617)
- Carious teeth (HP:0000670): Caries is a multifactorial bacterial infection affecting the structure of the tooth. This term has been used to describe the presence of more than expected dental caries. Evidence: TAS. Frequency: Very frequent (HP:0040281). (ORPHA:2617)
- Dry skin (HP:0000958): Skin characterized by the lack of natural or normal moisture. Evidence: TAS. Frequency: Very frequent (HP:0040281). (ORPHA:2617)
- Hyperhidrosis (HP:0000975): Abnormal excessive perspiration (sweating) despite the lack of appropriate stimuli like hot and humid weather. Evidence: TAS. Frequency: Very frequent (HP:0040281). (ORPHA:2617)
- Intellectual disability (HP:0001249): The term intellectual disability or intellectual developmental disorder is used to describe significantly sub-average intellectual and adaptive functioning based on clinical assessment and as measured by individually administered, appropriately normed, standardized and validated tests of intellectual functioning and adaptive behavior, with onset during the developmental period from infancy through adolescence. Evidence: TAS. Frequency: Very frequent (HP:0040281). (ORPHA:2617)